Phenotypes associated with the disease trichotillomania (OMIM:613229):
- Hair-pulling (HP:0012167): A phenomenon in which persons repetitively pull out their own hair, resulting in noticeable hair loss. Evidence: IEA. (OMIM:613229)
- Alopecia (HP:0001596): A noncongenital process of hair loss, which may progress to partial or complete baldness. Evidence: IEA. (OMIM:613229)
- Compulsive behaviors (HP:0000722): Behavior that consists of repetitive acts, characterized by the feeling that one "has to" perform them, while being aware that these acts are not in line with one's overall goal. Evidence: IEA. (OMIM:613229)
- Non-Mendelian inheritance (HP:0001426): A mode of inheritance that depends on genetic determinants in more than one gene. Evidence: IEA. (OMIM:613229)
- Autosomal dominant inheritance (HP:0000006): A mode of inheritance that is observed for traits related to a gene encoded on one of the autosomes (i.e., the human chromosomes 1-22) in which a trait manifests in heterozygotes. In the context of medical genetics, an autosomal dominant disorder is caused when a single copy of the mutant allele is present. Males and females are affected equally, and can both transmit the disorder with a risk of 50% for each child of inheriting the mutant allele. Evidence: IEA. (OMIM:613229)